Phenotypes associated with the disease ichthyosis-cheek-eyebrow syndrome (OMIM:146720):
- Kyphoscoliosis (HP:0002751): An abnormal curvature of the spine in both a coronal (lateral) and sagittal (back-to-front) plane. Evidence: IEA. (OMIM:146720)
- Ichthyosis (HP:0008064): An abnormality of the skin characterized the presence of excessive amounts of dry surface scales on the skin resulting from an abnormality of keratinization. Evidence: IEA. (OMIM:146720)
- Full cheeks (HP:0000293): Increased prominence or roundness of soft tissues between zygomata and mandible. Evidence: IEA. (OMIM:146720)
- High palate (HP:0000218): Height of the palate more than 2 SD above the mean (objective) or palatal height at the level of the first permanent molar more than twice the height of the teeth (subjective). Evidence: IEA. (OMIM:146720)
- Pes planus (HP:0001763): A foot where the longitudinal arch of the foot is in contact with the ground or floor when the individual is standing; or, in a patient lying supine, a foot where the arch is in contact with the surface of a flat board pressed against the sole of the foot by the examiner with a pressure similar to that expected from weight bearing; or, the height of the arch is reduced. Evidence: IEA. (OMIM:146720)
- Autosomal dominant inheritance (HP:0000006): A mode of inheritance that is observed for traits related to a gene encoded on one of the autosomes (i.e., the human chromosomes 1-22) in which a trait manifests in heterozygotes. In the context of medical genetics, an autosomal dominant disorder is caused when a single copy of the mutant allele is present. Males and females are affected equally, and can both transmit the disorder with a risk of 50% for each child of inheriting the mutant allele. Evidence: IEA. (OMIM:146720)
- Abnormal thorax morphology (HP:0000765): Any abnormality of the thorax (the region of the body formed by the sternum, the thoracic vertebrae and the ribs). Evidence: IEA. (OMIM:146720)
- Sparse lateral eyebrow (HP:0005338): Decreased density/number and/or decreased diameter of lateral eyebrow hairs. Evidence: IEA. (OMIM:146720)